- Multicystic kidney dysplasia (HP:0000003): Multicystic dysplasia of the kidney is characterized by multiple cysts of varying size in the kidney and the absence of a normal pelvicaliceal system. The condition is associated with ureteral or ureteropelvic atresia, and the affected kidney is nonfunctional. Evidence: TAS. Frequency: Frequent (HP:0040282). (ORPHA:3270)
- Abnormality of the dentition (HP:0000164): Any abnormality of the teeth. Evidence: TAS. Frequency: Frequent (HP:0040282). (ORPHA:3270)
- Abnormal palate morphology (HP:0000174): Any abnormality of the palate, i.e., of roof of the mouth. Evidence: TAS. Frequency: Very frequent (HP:0040281). (ORPHA:3270)
- Macrocephaly (HP:0000256): Occipitofrontal (head) circumference greater than 97th centile compared to appropriate, age matched, sex-matched normal standards. Alternatively, a apparently increased size of the cranium. Evidence: TAS. Frequency: Very frequent (HP:0040281). (ORPHA:3270)
- Dolichocephaly (HP:0000268): An abnormality of skull shape characterized by a increased anterior-posterior diameter, i.e., an increased antero-posterior dimension of the skull. Cephalic index less than 76%. Alternatively, an apparently increased antero-posterior length of the head compared to width. Often due to premature closure of the sagittal suture. Evidence: TAS. Frequency: Very frequent (HP:0040281). (ORPHA:3270)
- Narrow face (HP:0000275): Bizygomatic (upper face) and bigonial (lower face) width are both more than 2 standard deviations below the mean (objective); or, an apparent reduction in the width of the upper and lower face (subjective). Evidence: TAS. Frequency: Very frequent (HP:0040281). (ORPHA:3270)
- Hearing abnormality (HP:0000364): An abnormality of the sensory perception of sound. Evidence: TAS. Frequency: Very frequent (HP:0040281). (ORPHA:3270)
- Protruding ear (HP:0000411): Angle formed by the plane of the ear and the mastoid bone greater than the 97th centile for age (objective); or, outer edge of the helix more than 2 cm from the mastoid at the point of maximum distance (objective). Evidence: TAS. Frequency: Very frequent (HP:0040281). (ORPHA:3270)
- Prominent nasal bridge (HP:0000426): Anterior positioning of the nasal root in comparison to the usual positioning for age. Evidence: TAS. Frequency: Very frequent (HP:0040281). (ORPHA:3270)
- Prominent nose (HP:0000448): Distance between subnasale and pronasale more than two standard deviations above the mean, or alternatively, an apparently increased anterior protrusion of the nasal tip. Evidence: TAS. Frequency: Very frequent (HP:0040281). (ORPHA:3270)
- Strabismus (HP:0000486): A misalignment of the eyes so that the visual axes deviate from bifoveal fixation. The classification of strabismus may be based on a number of features including the relative position of the eyes, whether the deviation is latent or manifest, intermittent or constant, concomitant or otherwise and according to the age of onset and the relevance of any associated refractive error. Evidence: TAS. Frequency: Very frequent (HP:0040281). (ORPHA:3270)
- Carious teeth (HP:0000670): Caries is a multifactorial bacterial infection affecting the structure of the tooth. This term has been used to describe the presence of more than expected dental caries. Evidence: TAS. Frequency: Frequent (HP:0040282). (ORPHA:3270)
- Pectus excavatum (HP:0000767): A defect of the chest wall characterized by a depression of the sternum, giving the chest ("pectus") a caved-in ("excavatum") appearance. Evidence: TAS. Frequency: Very frequent (HP:0040281). (ORPHA:3270)
- Hypotonia (HP:0001252): Hypotonia is an abnormally low muscle tone (the amount of tension or resistance to movement in a muscle). Even when relaxed, muscles have a continuous and passive partial contraction which provides some resistance to passive stretching. Hypotonia thus manifests as diminished resistance to passive stretching. Hypotonia is not the same as muscle weakness, although the two conditions can co-exist. Evidence: TAS. Frequency: Very frequent (HP:0040281). (ORPHA:3270)
- Global developmental delay (HP:0001263): A delay in the achievement of motor or mental milestones in the domains of development of a child, including motor skills, speech and language, cognitive skills, and social and emotional skills. This term should only be used to describe children younger than five years of age. Evidence: TAS. Frequency: Very frequent (HP:0040281). (ORPHA:3270)
- Gait disturbance (HP:0001288): The term gait disturbance can refer to any disruption of the ability to walk. Evidence: TAS. Frequency: Very frequent (HP:0040281). (ORPHA:3270)
- Abnormal speech pattern (HP:0002167): An abnormality in the sound (volume) or cadence (rate) of speech. Evidence: TAS. Frequency: Very frequent (HP:0040281). (ORPHA:3270)
- Radioulnar synostosis (HP:0002974): An abnormal osseous union (fusion) between the radius and the ulna. Evidence: TAS. Frequency: Very frequent (HP:0040281). (ORPHA:3270)
- Abnormality of the musculature (HP:0003011): Abnormality originating in one or more muscles, i.e., of the set of muscles of body. Evidence: TAS. Frequency: Very frequent (HP:0040281). (ORPHA:3270)
- Abnormal dermatoglyphics (HP:0007477): An abnormality of dermatoglyphs (fingerprints), which are present on fingers, palms, toes, and soles. Evidence: TAS. Frequency: Very frequent (HP:0040281). (ORPHA:3270)
These phenotypes are associated with the disease Radioulnar synostosis-developmental delay-hypotonia syndrome (ORPHA:3270).